- Pectus carinatum (HP:0000768): A deformity of the chest caused by overgrowth of the ribs and characterized by protrusion of the sternum. Evidence: TAS. Frequency: Frequent (HP:0040282). (ORPHA:98902)
- Motor delay (HP:0001270): A type of Developmental delay characterized by a delay in acquiring motor skills. Evidence: TAS. Frequency: Frequent (HP:0040282). (ORPHA:98902)
- Neonatal hypotonia (HP:0001319): Muscular hypotonia (abnormally low muscle tone) manifesting in the neonatal period. Evidence: TAS. Frequency: Frequent (HP:0040282). (ORPHA:98902)
- Tremor (HP:0001337): An unintentional, oscillating to-and-fro muscle movement about a joint axis. Evidence: TAS. Frequency: Frequent (HP:0040282). (ORPHA:98902)
- Shoulder flexion contracture (HP:0003044): Chronic reduction in active and passive mobility of the shoulder joint due to structural changes in muscle, tendons, ligaments, or skin that prevents normal movement. Evidence: TAS. Frequency: Frequent (HP:0040282). (ORPHA:98902)
- Hip contracture (HP:0003273): Lack of full passive range of motion (restrictions in flexion, extension, or other movements) of the hip joint resulting from structural changes of non-bony tissues, such as muscles, tendons, ligaments, joint capsules and/or skin. Evidence: TAS. Frequency: Frequent (HP:0040282). (ORPHA:98902)
- Progressive muscle weakness (HP:0003323). Evidence: TAS. Frequency: Frequent (HP:0040282). (ORPHA:98902)
- EMG: myopathic abnormalities (HP:0003458): The presence of abnormal electromyographic patterns indicative of myopathy, such as small-short polyphasic motor unit potentials. Evidence: TAS. Frequency: Frequent (HP:0040282). (ORPHA:98902)
- Type 1 muscle fiber predominance (HP:0003803): An abnormal predominance of type I muscle fibers (in general, this feature can only be observed on muscle biopsy). Evidence: TAS. Frequency: Frequent (HP:0040282). (ORPHA:98902)
- Proximal amyotrophy (HP:0007126): Amyotrophy (muscular atrophy) affecting the proximal musculature. Evidence: TAS. Frequency: Frequent (HP:0040282). (ORPHA:98902)
- Respiratory insufficiency due to muscle weakness (HP:0002747). Evidence: TAS. Frequency: Occasional (HP:0040283). (ORPHA:98902)
These phenotypes are associated with the disease Amish nemaline myopathy (ORPHA:98902).
The following phenotypes are NOT associated with this disease:
- Intellectual disability (HP:0001249): The term intellectual disability or intellectual developmental disorder is used to describe significantly sub-average intellectual and adaptive functioning based on clinical assessment and as measured by individually administered, appropriately normed, standardized and validated tests of intellectual functioning and adaptive behavior, with onset during the developmental period from infancy through adolescence. Evidence: TAS. (ORPHA:98902)